- Abnormal finger morphology (HP:0001167): An anomaly of a finger. Evidence: TAS. Frequency: Very frequent (HP:0040281). (ORPHA:2730)
- Abnormal metacarpal morphology (HP:0005916): Any abnormal shape or structure of the metacarpal bones. Evidence: TAS. Frequency: Very frequent (HP:0040281). (ORPHA:2730)
- Oligodactyly (HP:0012165): A developmental defect resulting in the presence of fewer than the normal number of digits. Evidence: TAS. Frequency: Very frequent (HP:0040281). (ORPHA:2730)
- Ectrodactyly (HP:0100257): A condition in which middle parts of the hands and/or feet (digits and meta-carpals and -tarsals) are missing giving a cleft appearance. The severity is very variable ranging from slightly hypoplastic 3rd toe/fingers over absent 2nd or 3rd toes/fingers as far as oligo- or monodactyl hands and/or feet. Evidence: TAS. Frequency: Very frequent (HP:0040281). (ORPHA:2730)
These phenotypes are associated with the disease Postaxial tetramelic oligodactyly (ORPHA:2730).